Phenotypes associated with the disease Edinburgh malformation syndrome (ORPHA:1895):
- Narrow mouth (HP:0000160): Distance between the commissures of the mouth more than 2 SD below the mean. Alternatively, an apparently decreased width of the oral aperture (subjective). Evidence: TAS. Frequency: Occasional (HP:0040283). (ORPHA:1895)
- Thin vermilion border (HP:0000233): Height of the vermilion of the medial part of the lip more than 2 SD below the mean, or apparently reduced height of the vermilion of the lip in the frontal view. The vermilion is the red part of the lips (and confusingly, the vermilion itself is also often referred to as being equivalent the lips). Evidence: TAS. Frequency: Very frequent (HP:0040281). (ORPHA:1895)
- Hydrocephalus (HP:0000238): Hydrocephalus is an active distension of the ventricular system of the brain resulting from inadequate passage of CSF from its point of production within the cerebral ventricles to its point of absorption into the systemic circulation. Evidence: TAS. Frequency: Frequent (HP:0040282). (ORPHA:1895)
- Micrognathia (HP:0000347): Developmental hypoplasia of the mandible. Evidence: TAS. Frequency: Frequent (HP:0040282). (ORPHA:1895)
- Low-set ears (HP:0000369): Upper insertion of the ear to the scalp below an imaginary horizontal line drawn between the inner canthi of the eye and extending posteriorly to the ear. Evidence: TAS. Frequency: Frequent (HP:0040282). (ORPHA:1895)
- Choanal atresia (HP:0000453): Absence or abnormal closure of the choana (the posterior nasal aperture). Most embryologists believe that posterior choanal atresia results from a failure of rupture between the 35th and 38th day of fetal life of the partition which separates the bucconasal or buccopharyngeal membranes. The resultant choanal atresia may be unilateral or bilateral, bony or membranous, complete or incomplete. In over 90 per cent of cases the obstruction is bony, while in the remainder it is membranous. The bony type of atresia is commonly located 1-2 mm. anterior to the posterior edge of the hard palate, and the osseous septum varies in thickness from 1 to 10 mm. In the membranous form of choanal atresia the obstruction usually occurs further posteriorly. In approximately one third of cases the atresia is bilateral. Evidence: TAS. Frequency: Very frequent (HP:0040281). (ORPHA:1895)
- Anteverted nares (HP:0000463): Anteriorly-facing nostrils viewed with the head in the Frankfurt horizontal and the eyes of the observer level with the eyes of the subject. This gives the appearance of an upturned nose (upturned nasal tip). Evidence: TAS. Frequency: Frequent (HP:0040282). (ORPHA:1895)
- Synophrys (HP:0000664): Meeting of the medial eyebrows in the midline. Evidence: TAS. Frequency: Frequent (HP:0040282). (ORPHA:1895)
- Hirsutism (HP:0001007): Abnormally increased hair growth referring to a male pattern of body hair (androgenic hair). Evidence: TAS. Frequency: Very frequent (HP:0040281). (ORPHA:1895)
- Brushfield spots (HP:0001088): The presence of whitish spots in a ring-like arrangement at the periphery of the iris. Evidence: TAS. Frequency: Occasional (HP:0040283). (ORPHA:1895)
- Slender finger (HP:0001238): Fingers that are disproportionately narrow (reduced girth) for the hand/foot size or build of the individual. Evidence: TAS. Frequency: Frequent (HP:0040282). (ORPHA:1895)
- Intellectual disability (HP:0001249): The term intellectual disability or intellectual developmental disorder is used to describe significantly sub-average intellectual and adaptive functioning based on clinical assessment and as measured by individually administered, appropriately normed, standardized and validated tests of intellectual functioning and adaptive behavior, with onset during the developmental period from infancy through adolescence. Evidence: TAS. Frequency: Very frequent (HP:0040281). (ORPHA:1895)
- Seizure (HP:0001250): A seizure is an intermittent abnormality of nervous system physiology characterized by a transient occurrence of signs and/or symptoms due to abnormal excessive or synchronous neuronal activity in the brain. Evidence: TAS. Frequency: Frequent (HP:0040282). (ORPHA:1895)
- Hypertonia (HP:0001276): A condition in which there is increased muscle tone so that arms or legs, for example, are stiff and difficult to move. Evidence: TAS. Frequency: Frequent (HP:0040282). (ORPHA:1895)
- Joint stiffness (HP:0001387): Joint stiffness is a perceived sensation of tightness in a joint or joints when attempting to move them after a period of inactivity. Joint stiffness typically subsides over time. Evidence: TAS. Frequency: Occasional (HP:0040283). (ORPHA:1895)
- Failure to thrive (HP:0001508): Failure to thrive (FTT) refers to a child whose physical growth is substantially below the norm. Evidence: TAS. Frequency: Very frequent (HP:0040281). (ORPHA:1895)
- Abnormality of the voice (HP:0001608). Evidence: TAS. Frequency: Very frequent (HP:0040281). (ORPHA:1895)
- Frontal bossing (HP:0002007): Bilateral bulging of the lateral frontal bone prominences with relative sparing of the midline. Evidence: TAS. Frequency: Very frequent (HP:0040281). (ORPHA:1895)
- Respiratory insufficiency (HP:0002093). Evidence: TAS. Frequency: Very frequent (HP:0040281). (ORPHA:1895)
- Low posterior hairline (HP:0002162): Hair on the neck extends more inferiorly than usual. Evidence: TAS. Frequency: Frequent (HP:0040282). (ORPHA:1895)
- Generalized hirsutism (HP:0002230): Abnormally increased hair growth over much of the entire body. Evidence: TAS. Frequency: Frequent (HP:0040282). (ORPHA:1895)
- Abnormality of neuronal migration (HP:0002269): An abnormality resulting from an anomaly of neuronal migration, i.e., of the process by which neurons travel from their origin to their final position in the brain. Evidence: TAS. Frequency: Occasional (HP:0040283). (ORPHA:1895)
- Downturned corners of mouth (HP:0002714): A morphological abnormality of the mouth in which the angle of the mouth is downturned. The oral commissures are positioned inferior to the midline labial fissure. Evidence: TAS. Frequency: Very frequent (HP:0040281). (ORPHA:1895)
- Short nose (HP:0003196): Distance from nasion to subnasale more than two standard deviations below the mean, or alternatively, an apparently decreased length from the nasal root to the nasal tip. Evidence: TAS. Frequency: Frequent (HP:0040282). (ORPHA:1895)
- Accelerated skeletal maturation (HP:0005616): An abnormally increased rate of skeletal maturation. Accelerated skeletal maturation can be diagnosed on the basis of an estimation of the bone age from radiographs of specific bones in the human body. Evidence: TAS. Frequency: Occasional (HP:0040283). (ORPHA:1895)
- Aplasia/Hypoplasia affecting the eye (HP:0008056). Evidence: TAS. Frequency: Very frequent (HP:0040281). (ORPHA:1895)
- Ulnar deviation of finger (HP:0009465): Bending or curvature of a finger toward the ulnar side (i.e., away from the thumb). The deviation is at the metacarpal-phalangeal joint, and this finding is distinct from clinodactyly. Evidence: TAS. Frequency: Occasional (HP:0040283). (ORPHA:1895)
- Long fingers (HP:0100807): The middle finger is more than 2 SD above the mean for newborns 27 to 41 weeks EGA or above the 97th centile for children from birth to 16 years of age AND the five digits retain their normal length proportions relative to each other (i.e., it is not the case that the middle finger is the only lengthened digit), or, Fingers that appear disproportionately long compared to the palm of the hand. Evidence: TAS. Frequency: Frequent (HP:0040282). (ORPHA:1895)